- Duplicated collecting system (HP:0000081): A duplication of the collecting system of the kidney, defined as a kidney with two (instead of, normally, one) pyelocaliceal systems. The pyelocaliceal system is comprised of the renal pelvis and calices. The duplicated renal collecting system can be associated with a single ureter or with double ureters. In the latter case, the two ureters empty separately into the bladder or fuse to form a single ureteral orifice. Evidence: IEA. (OMIM:163850)
- Autosomal dominant inheritance (HP:0000006): A mode of inheritance that is observed for traits related to a gene encoded on one of the autosomes (i.e., the human chromosomes 1-22) in which a trait manifests in heterozygotes. In the context of medical genetics, an autosomal dominant disorder is caused when a single copy of the mutant allele is present. Males and females are affected equally, and can both transmit the disorder with a risk of 50% for each child of inheriting the mutant allele. Evidence: IEA. (OMIM:163850)
- Hydronephrosis (HP:0000126): Severe distention of the kidney with dilation of the renal pelvis and calices. Evidence: IEA. (OMIM:163850)
- Abnormality of the skin (HP:0000951): An abnormality of the skin. Evidence: IEA. (OMIM:163850)
These phenotypes are associated with the disease noduli Cutanei, multiple, with urinary tract abnormalities (OMIM:163850).